- Abnormal clavicle morphology (HP:0000889): Any abnormality of the clavicles (collar bones). Evidence: TAS. Frequency: Very frequent (HP:0040281). (ORPHA:85197)
- Abnormality of the knee (HP:0002815): An abnormality of the knee joint or surrounding structures. Evidence: TAS. Frequency: Very frequent (HP:0040281). (ORPHA:85197)
- Multiple enchondromatosis (HP:0005701). Evidence: TAS. Frequency: Very frequent (HP:0040281). (ORPHA:85197)
These phenotypes are associated with the disease Genochondromatosis type 1 (ORPHA:85197).